Phenotypes associated with the disease microbrachycephaly-ptosis-cleft lip syndrome (OMIM:268850):
- Narrow forehead (HP:0000341): Width of the forehead or distance between the frontotemporales is more than two standard deviations below the mean (objective); or apparently narrow intertemporal region (subjective). Evidence: IEA. (OMIM:268850)
- Palmoplantar cutis laxa (HP:0007517): Loose, wrinkled skin of hands and feet. Evidence: IEA. (OMIM:268850)
- Strabismus (HP:0000486): A misalignment of the eyes so that the visual axes deviate from bifoveal fixation. The classification of strabismus may be based on a number of features including the relative position of the eyes, whether the deviation is latent or manifest, intermittent or constant, concomitant or otherwise and according to the age of onset and the relevance of any associated refractive error. Evidence: IEA. (OMIM:268850)
- Hearing impairment (HP:0000365): A decreased magnitude of the sensory perception of sound. Evidence: TAS. (OMIM:268850)
- Short stature (HP:0004322): A height below that which is expected according to age and gender norms. Although there is no universally accepted definition of short stature, many refer to "short stature" as height more than 2 standard deviations below the mean for age and gender (or below the 3rd percentile for age and gender dependent norms). Evidence: IEA. (OMIM:268850)
- Gait ataxia (HP:0002066): A type of ataxia characterized by the impairment of the ability to coordinate the movements required for normal walking. Gait ataxia is characteirzed by a wide-based staggering gait with a tendency to fall. Evidence: TAS. (OMIM:268850)
- Spina bifida occulta (HP:0003298): The closed form of spina bifida with incomplete closure of a vertebral body with intact overlying skin. Evidence: TAS. (OMIM:268850)
- Hypotonia (HP:0001252): Hypotonia is an abnormally low muscle tone (the amount of tension or resistance to movement in a muscle). Even when relaxed, muscles have a continuous and passive partial contraction which provides some resistance to passive stretching. Hypotonia thus manifests as diminished resistance to passive stretching. Hypotonia is not the same as muscle weakness, although the two conditions can co-exist. Evidence: TAS. (OMIM:268850)
- Generalized hypotonia (HP:0001290): Generalized muscular hypotonia (abnormally low muscle tone). Evidence: TAS. (OMIM:268850)
- Nystagmus (HP:0000639): Rhythmic, involuntary oscillations of one or both eyes related to abnormality in fixation, conjugate gaze, or vestibular mechanisms. Evidence: TAS. (OMIM:268850)
- Autism (HP:0000717): Autism is a neurodevelopmental disorder characterized by impaired social interaction and communication, and by restricted and repetitive behavior. Autism begins in childhood. It is marked by the presence of markedly abnormal or impaired development in social interaction and communication and a markedly restricted repertoire of activity and interest. Manifestations of the disorder vary greatly depending on the developmental level and chronological age of the individual (DSM-IV). Evidence: TAS. (OMIM:268850)
- Iris coloboma (HP:0000612): A coloboma of the iris. Evidence: TAS. (OMIM:268850)
- Intellectual disability (HP:0001249): The term intellectual disability or intellectual developmental disorder is used to describe significantly sub-average intellectual and adaptive functioning based on clinical assessment and as measured by individually administered, appropriately normed, standardized and validated tests of intellectual functioning and adaptive behavior, with onset during the developmental period from infancy through adolescence. Evidence: IEA. (OMIM:268850)
- Prominent supraorbital ridges (HP:0000336): Greater than average forward and/or lateral protrusion of the supraorbital portion of the frontal bones. Evidence: TAS. (OMIM:268850)
- Narrow face (HP:0000275): Bizygomatic (upper face) and bigonial (lower face) width are both more than 2 standard deviations below the mean (objective); or, an apparent reduction in the width of the upper and lower face (subjective). Evidence: TAS. (OMIM:268850)
- Microcephaly (HP:0000252): Head circumference below 2 standard deviations below the mean for age and gender. Evidence: TAS. (OMIM:268850)
- Downslanted palpebral fissures (HP:0000494): The palpebral fissure inclination is more than two standard deviations below the mean. Evidence: TAS. (OMIM:268850)
- Cleft palate (HP:0000175): Cleft palate is a developmental defect of the palate resulting from a failure of fusion of the palatine processes and manifesting as a separation of the roof of the mouth (soft and hard palate). Evidence: TAS. (OMIM:268850)
- Long face (HP:0000276): Facial height (length) is more than 2 standard deviations above the mean (objective); or, an apparent increase in the height (length) of the face (subjective). Evidence: TAS. (OMIM:268850)
- Deeply set eye (HP:0000490): An eye that is more deeply recessed into the plane of the face than is typical. Evidence: TAS. (OMIM:268850)
- Malar flattening (HP:0000272): Underdevelopment of the malar prominence of the jugal bone (zygomatic bone in mammals), appreciated in profile, frontal view, and/or by palpation. Evidence: IEA. (OMIM:268850)
- Underdeveloped supraorbital ridges (HP:0009891): Flatness of the supraorbital portion of the frontal bones. Evidence: TAS. (OMIM:268850)
- Abnormal digit morphology (HP:0011297): A morphological abnormality of a digit, i.e., of a finger or toe. Evidence: TAS. (OMIM:268850)
- Ptosis (HP:0000508): The upper eyelid margin is positioned 3 mm or more lower than usual and covers the superior portion of the iris (objective); or, the upper lid margin obscures at least part of the pupil (subjective). Evidence: TAS. (OMIM:268850)
- Pectus excavatum (HP:0000767): A defect of the chest wall characterized by a depression of the sternum, giving the chest ("pectus") a caved-in ("excavatum") appearance. Evidence: IEA. (OMIM:268850)
- Autosomal recessive inheritance (HP:0000007): A mode of inheritance that is observed for traits related to a gene encoded on one of the autosomes (i.e., the human chromosomes 1-22) in which a trait manifests in individuals with two pathogenic alleles, either homozygotes (two copies of the same mutant allele) or compound heterozygotes (whereby each copy of a gene has a distinct mutant allele). Evidence: IEA. (OMIM:268850)
- Hypotelorism (HP:0000601): Interpupillary distance less than 2 SD below the mean (alternatively, the appearance of an decreased interpupillary distance or closely spaced eyes). Evidence: IEA. (OMIM:268850)
- Eyelid coloboma (HP:0000625): A short discontinuity of the margin of the lower or upper eyelid. Evidence: TAS. (OMIM:268850)
- Esotropia (HP:0000565): A form of strabismus with one or both eyes turned inward ('crossed') to a relatively severe degree, usually defined as 10 diopters or more. Evidence: TAS. (OMIM:268850)
- Cleft upper lip (HP:0000204): A gap or groove in the upper lip. This is a congenital defect resulting from nonfusion of tissues of the lip during embryonal development. Evidence: IEA. (OMIM:268850)
- Brachycephaly (HP:0000248): An abnormality of skull shape characterized by a decreased anterior-posterior diameter. That is, a cephalic index greater than 81%. Alternatively, an apparently shortened anteroposterior dimension (length) of the head compared to width. Evidence: TAS. (OMIM:268850)
- Mandibular prognathia (HP:0000303): Abnormal prominence of the chin related to increased length of the mandible. Evidence: TAS. (OMIM:268850)